Phenotypes associated with the disease Partington syndrome (ORPHA:94083):
- Triangular face (HP:0000325): Facial contour, as viewed from the front, triangular in shape, with breadth at the temples and tapering to a narrow chin. Evidence: TAS. Frequency: Very frequent (HP:0040281). (ORPHA:94083)
- Intellectual disability (HP:0001249): The term intellectual disability or intellectual developmental disorder is used to describe significantly sub-average intellectual and adaptive functioning based on clinical assessment and as measured by individually administered, appropriately normed, standardized and validated tests of intellectual functioning and adaptive behavior, with onset during the developmental period from infancy through adolescence. Evidence: TAS. Frequency: Very frequent (HP:0040281). (ORPHA:94083)
- Limb dystonia (HP:0002451): A type of dystonia (abnormally increased muscular tone causing fixed abnormal postures) that affects muscles of the limbs. Evidence: TAS. Frequency: Very frequent (HP:0040281). (ORPHA:94083)
- Macroorchidism (HP:0000053): The presence of abnormally large testes. Evidence: TAS. Frequency: Frequent (HP:0040282). (ORPHA:94083)
- Mild intellectual disability (HP:0001256): Mild intellectual disability (ID) is defined as a type of ID characterized by mildly sub-average adaptive functioning and intellectual functioning, with an intelligence quotient (IQ) the range of 50-69. Evidence: TAS. Frequency: Frequent (HP:0040282). (ORPHA:94083)
- Dysarthria (HP:0001260): Dysarthric speech is a general description referring to a neurological speech disorder characterized by poor articulation. Depending on the involved neurological structures, dysarthria may be further classified as spastic, flaccid, ataxic, hyperkinetic and hypokinetic, or mixed. Evidence: TAS. Frequency: Frequent (HP:0040282). (ORPHA:94083)
- Gait disturbance (HP:0001288): The term gait disturbance can refer to any disruption of the ability to walk. Evidence: TAS. Frequency: Frequent (HP:0040282). (ORPHA:94083)
- Lower limb spasticity (HP:0002061): Spasticity (velocity-dependent increase in tonic stretch reflexes with increased muscle tone and hyperexcitable tendon reflexes) in the muscles of the lower limbs, hips, and pelvis. Evidence: TAS. Frequency: Frequent (HP:0040282). (ORPHA:94083)
- Moderate intellectual disability (HP:0002342): Moderate intellectual disability (ID) is defined as a type of ID characterized by moderately sub-average adaptive functioning and intellectual functioning, with an intelligence quotient (IQ) the range of 35-49. Evidence: TAS. Frequency: Frequent (HP:0040282). (ORPHA:94083)
- Delayed speech and language development (HP:0000750): A degree of language development that is significantly below the norm for a child of a specified age. Evidence: TAS. Frequency: Occasional (HP:0040283). (ORPHA:94083)
- Seizure (HP:0001250): A seizure is an intermittent abnormality of nervous system physiology characterized by a transient occurrence of signs and/or symptoms due to abnormal excessive or synchronous neuronal activity in the brain. Evidence: TAS. Frequency: Occasional (HP:0040283). (ORPHA:94083)
- EEG abnormality (HP:0002353): Abnormality observed by electroencephalogram (EEG), which is used to record of the brain's spontaneous electrical activity from multiple electrodes placed on the scalp. Evidence: TAS. Frequency: Occasional (HP:0040283). (ORPHA:94083)
- Facial telangiectasia (HP:0007380): Telangiectases (small dilated blood vessels) located near the surface of the skin of the face. Evidence: TAS. Frequency: Occasional (HP:0040283). (ORPHA:94083)